Phenotypes associated with the disease Hyperkeratosis-hyperpigmentation syndrome (ORPHA:1336):
- Hyperkeratosis (HP:0000962): Hyperkeratosis is a histopathological term defining a thickened stratum corneum and may be present in many different skin conditions, with many possible overlaps. Hyperkeratosis refers to the increased thickness of the stratum corneum, the outer layer of the skin. Hyperkeratosis is subclassified as orthokeratotic or parakeratotic. Orthokeratotic hyperkeratosis refers to the thickening of the keratin layer with preserved keratinocyte maturation, while parakeratotic hyperkeratosis shows retained nuclei as a sign of delayed maturation of keratinocytes. Evidence: TAS. Frequency: Very frequent (HP:0040281). (ORPHA:1336)
- Cutaneous photosensitivity (HP:0000992): An increased sensitivity of the skin to light. Photosensitivity may result in a rash upon exposure to the sun (which is known as photodermatosis). Photosensitivity can be diagnosed by phototests in which light is shone on small areas of skin. Evidence: TAS. Frequency: Frequent (HP:0040282). (ORPHA:1336)
- Irregular hyperpigmentation (HP:0007400). Evidence: TAS. Frequency: Very frequent (HP:0040281). (ORPHA:1336)
- Multiple cafe-au-lait spots (HP:0007565): The presence of six or more cafe-au-lait spots. Evidence: TAS. Frequency: Frequent (HP:0040282). (ORPHA:1336)
- Papule (HP:0200034): A circumscribed, solid elevation of skin with no visible fluid, varying in size from a pinhead to less than 10mm in diameter at the widest point. Evidence: TAS. Frequency: Very frequent (HP:0040281). (ORPHA:1336)